- Edema (HP:0000969): An abnormal accumulation of fluid beneath the skin, or in one or more cavities of the body. Evidence: TAS. Frequency: Very frequent (HP:0040281). (ORPHA:345)
- Pruritus (HP:0000989): Pruritus is an itch or a sensation that makes a person want to scratch. This term refers to an abnormally increased disposition to experience pruritus. Evidence: TAS. Frequency: Very frequent (HP:0040281). (ORPHA:345)
- Subcutaneous nodule (HP:0001482): Slightly elevated lesions on or in the skin with a diameter of over 5 mm. Evidence: TAS. Frequency: Very frequent (HP:0040281). (ORPHA:345)
- Recurrent skin infections (HP:0001581): Infections of the skin that happen multiple times. Evidence: TAS. Frequency: Very frequent (HP:0040281). (ORPHA:345)
- Abnormal hair morphology (HP:0001595): An abnormality of the hair. Evidence: TAS. Frequency: Very frequent (HP:0040281). (ORPHA:345)
- Cellulitis (HP:0100658): A bacterial infection and inflammation of the skin und subcutaneous tissues. Evidence: TAS. Frequency: Very frequent (HP:0040281). (ORPHA:345)
- Scalp tenderness (HP:0100809): Pain or discomfort of the scalp elicited by palpation. Evidence: TAS. Frequency: Very frequent (HP:0040281). (ORPHA:345)
These phenotypes are associated with the disease Dissecting cellulitis of the scalp (ORPHA:345).